- Hyperreflexia (HP:0001347): Hyperreflexia is the presence of hyperactive stretch reflexes of the muscles. Evidence: TAS. Frequency: Frequent (HP:0040282). (ORPHA:59298)
- Headache (HP:0002315): Cephalgia, or pain sensed in various parts of the head, not confined to the area of distribution of any nerve. Evidence: TAS. Frequency: Frequent (HP:0040282). (ORPHA:59298)
- Progressive neurologic deterioration (HP:0002344). Evidence: TAS. Frequency: Frequent (HP:0040282). (ORPHA:59298)
- Increased CSF protein concentration (HP:0002922): Increased concentration of protein in the cerebrospinal fluid. Evidence: TAS. Frequency: Frequent (HP:0040282). (ORPHA:59298)
- CNS demyelination (HP:0007305): A loss of myelin from nerve fibers in the central nervous system. Evidence: TAS. Frequency: Frequent (HP:0040282). (ORPHA:59298)
- Hyperintensity of cerebral white matter on MRI (HP:0030890): A brighter than expected signal on magnetic resonance imaging emanating from the cerebral white matter. Evidence: TAS. Frequency: Frequent (HP:0040282). (ORPHA:59298)
- Esotropia (HP:0000565): A form of strabismus with one or both eyes turned inward ('crossed') to a relatively severe degree, usually defined as 10 diopters or more. Evidence: TAS. Frequency: Occasional (HP:0040283). (ORPHA:59298)
- Diplopia (HP:0000651): Diplopia is a condition in which a single object is perceived as two images, it is also known as double vision. Evidence: TAS. Frequency: Occasional (HP:0040283). (ORPHA:59298)
- Seizure (HP:0001250): A seizure is an intermittent abnormality of nervous system physiology characterized by a transient occurrence of signs and/or symptoms due to abnormal excessive or synchronous neuronal activity in the brain. Evidence: TAS. Frequency: Occasional (HP:0040283). (ORPHA:59298)
- Ataxia (HP:0001251): Ataxia refers to impaired coordination of voluntary muscle movement. Cerebellar ataxia refers to ataxia due to dysfunction of the cerebellum. This causes a variety of elementary neurological deficits including asynergy (lack of coordination between muscles, limbs and joints), dysmetria (lack of ability to judge distances that can lead to under- or overshoot in grasping movements), and dysdiadochokinesia (inability to perform rapid movements requiring antagonizing muscle groups to be switched on and off repeatedly). Evidence: TAS. Frequency: Occasional (HP:0040283). (ORPHA:59298)
- Encephalopathy (HP:0001298): Encephalopathy is a term that means brain disease, damage, or malfunction. In general, encephalopathy is manifested by an altered mental state. Evidence: TAS. Frequency: Occasional (HP:0040283). (ORPHA:59298)
- Muscle weakness (HP:0001324): Reduced strength of muscles. Evidence: TAS. Frequency: Occasional (HP:0040283). (ORPHA:59298)
- Vomiting (HP:0002013): Forceful ejection of the contents of the stomach through the mouth by means of a series of involuntary spasmic contractions. Evidence: TAS. Frequency: Occasional (HP:0040283). (ORPHA:59298)
- Nausea (HP:0002018): A sensation of unease in the stomach together with an urge to vomit. Evidence: TAS. Frequency: Occasional (HP:0040283). (ORPHA:59298)
- Postural instability (HP:0002172): A tendency to fall or the inability to keep oneself from falling; imbalance. The retropulsion test is widely regarded as the gold standard to evaluate postural instability, Use of the retropulsion test includes a rapid balance perturbation in the backward direction, and the number of balance correcting steps (or total absence thereof) is used to rate the degree of postural instability. Healthy subjects correct such perturbations with either one or two large steps, or without taking any steps, hinging rapidly at the hips while swinging the arms forward as a counterweight. In patients with balance impairment, balance correcting steps are often too small, forcing patients to take more than two steps. Taking three or more steps is generally considered to be abnormal, and taking more than five steps is regarded as being clearly abnormal. Markedly affected patients continue to step backward without ever regaining their balance and must be caught by the examiner (this would be called true retropulsion). Even more severely affected patients fail to correct entirely, and fall backward like a pushed toy soldier, without taking any corrective steps. Evidence: TAS. Frequency: Occasional (HP:0040283). (ORPHA:59298)
- Vertigo (HP:0002321): An abnormal sensation of spinning while the body is actually stationary. Evidence: TAS. Frequency: Occasional (HP:0040283). (ORPHA:59298)
- Increased intracranial pressure (HP:0002516): An increase of the pressure inside the cranium (skull) and thereby in the brain tissue and cerebrospinal fluid. Evidence: TAS. Frequency: Occasional (HP:0040283). (ORPHA:59298)
- Ankle clonus (HP:0011448): Clonus is an involuntary tendon reflex that causes repeated flexion and extension of the foot. Ankle clonus is tested by rapidly flexing the foot upward. Evidence: TAS. Frequency: Occasional (HP:0040283). (ORPHA:59298)
- CSF pleocytosis (HP:0012229): An increased white blood cell count in the cerebrospinal fluid. Evidence: TAS. Frequency: Occasional (HP:0040283). (ORPHA:59298)
These phenotypes are associated with the disease Schilder disease (ORPHA:59298).